Phenotypes associated with the disease glaucoma 1, open angle, P (OMIM:177700):
- Adult onset (HP:0003581): Onset of disease manifestations in adulthood, defined here as at the age of 16 years or later. Evidence: PCS. (PMID:21447600)
- Open angle glaucoma (HP:0012108): A type of glaucoma defined by an open, normal appearing anterior chamber angle and raised intraocular pressure,. Evidence: PCS. (PMID:21447600)
- Increased cup-to-disc ratio (HP:0012796): An elevation in the ratio of the diameter of the cup of the optic disc to the total diameter of the disk. The optic disc has an orange-pink rim with a pale center (the cup) that does not contain neuroretinal tissue. An increase in this ratio therefore may indicate a decrease in the quantity of healthy neuroretinal cells. Evidence: PCS. (PMID:21447600)
- Glaucomatous visual field defect (HP:0007854). Evidence: PCS. (PMID:21447600)
- Autosomal dominant inheritance (HP:0000006): A mode of inheritance that is observed for traits related to a gene encoded on one of the autosomes (i.e., the human chromosomes 1-22) in which a trait manifests in heterozygotes. In the context of medical genetics, an autosomal dominant disorder is caused when a single copy of the mutant allele is present. Males and females are affected equally, and can both transmit the disorder with a risk of 50% for each child of inheriting the mutant allele. Evidence: PCS. (PMID:21447600)